Phenotypes associated with the disease schizophrenia 15 (OMIM:613950):
- Juvenile onset (HP:0003621): Onset of signs or symptoms of disease between the age of 5 and 15 years. Evidence: PCS. Frequency: 1/4. (PMID:20385823)
- Schizophrenia (HP:0100753): A mental disorder characterized by a disintegration of thought processes and emotional responsiveness. It most commonly manifests as auditory hallucinations, paranoid or bizarre delusions, or disorganized speech and thinking. It is accompanied by significant social or occupational dysfunction. The onset of symptoms typically occurs in young adulthood, with a global lifetime prevalence of about 1%. This term is not a helpful parent term to describe abnormal experiences. Evidence: PCS. Frequency: 4/4. (PMID:20385823)
- Young adult onset (HP:0011462): Onset of disease at the age of between 16 and 40 years. Evidence: PCS. Frequency: 3/4. (PMID:20385823)
- Hyperactivity (HP:0000752): Hyperactivity is a condition characterized by constant and unusually high levels of activity, even in situations where it is deemed inappropriate. Evidence: PCS. Frequency: 1/4. (PMID:20385823)
- Autosomal dominant inheritance (HP:0000006): A mode of inheritance that is observed for traits related to a gene encoded on one of the autosomes (i.e., the human chromosomes 1-22) in which a trait manifests in heterozygotes. In the context of medical genetics, an autosomal dominant disorder is caused when a single copy of the mutant allele is present. Males and females are affected equally, and can both transmit the disorder with a risk of 50% for each child of inheriting the mutant allele. Evidence: PCS. (PMID:20385823)
- Intellectual disability (HP:0001249): The term intellectual disability or intellectual developmental disorder is used to describe significantly sub-average intellectual and adaptive functioning based on clinical assessment and as measured by individually administered, appropriately normed, standardized and validated tests of intellectual functioning and adaptive behavior, with onset during the developmental period from infancy through adolescence. Evidence: PCS. Frequency: 2/4. (PMID:20385823)